- Elevated circulating growth hormone concentration (HP:0000845): Acromegaly is a condition resulting from overproduction of growth hormone by the pituitary gland in persons with closed epiphyses, and consists chiefly in the enlargement of the distal parts of the body. The circumference of the skull increases, the nose becomes broad, the tongue becomes enlarged, the facial features become coarsened, the mandible grows excessively, and the teeth become separated. The fingers and toes grow chiefly in thickness. Evidence: TAS. Frequency: Very frequent (HP:0040281). (ORPHA:97261)
- Coarse facial features (HP:0000280): Absence of fine and sharp appearance of brows, nose, lips, mouth, and chin, usually because of rounded and heavy features or thickened skin with or without thickening of subcutaneous and bony tissues. Evidence: TAS. Frequency: Frequent (HP:0040282). (ORPHA:97261)
- Abnormal abdomen morphology (HP:0001438): A structural abnormality of the abdomen ('belly'), that is, the part of the body between the pelvis and the thorax. Evidence: TAS. Frequency: Frequent (HP:0040282). (ORPHA:97261)
- Weight loss (HP:0001824): Reduction of total body weight. Evidence: TAS. Frequency: Frequent (HP:0040282). (ORPHA:97261)
- Diarrhea (HP:0002014): Abnormally increased frequency (usually defined as three or more) loose or watery bowel movements a day. Evidence: TAS. Frequency: Frequent (HP:0040282). (ORPHA:97261)
- Nausea and vomiting (HP:0002017): Nausea is a commonly encountered symptom that has been defined as an unpleasant painless subjective feeling that one will imminently vomit. Vomiting has been defined as the forceful expulsion of the contents of the stomach, duodenum, or jejunum through the oral cavity. While nausea and vomiting are often thought to exist on a temporal continuum, this is not always the case. There are situations when severe nausea may be present without emesis and less frequently, when emesis may be present without preceding nausea. Evidence: TAS. Frequency: Frequent (HP:0040282). (ORPHA:97261)
- Constipation (HP:0002019): Infrequent or difficult evacuation of feces. Evidence: TAS. Frequency: Frequent (HP:0040282). (ORPHA:97261)
- Anorexia (HP:0002039): Lack of desire to eat (loss of appetite). Evidence: TAS. Frequency: Frequent (HP:0040282). (ORPHA:97261)
- Zollinger-Ellison syndrome (HP:0002044): A condition in which there is increased production of gastrin by a gastrin-secreting tumor (usually located in the pancreas, duodenum, or abdominal lymph nodes) that stimulates the gastric mucosa to maximal activity, with consequent gastrointestinal mucosal ulceration. Evidence: TAS. Frequency: Frequent (HP:0040282). (ORPHA:97261)
- Hepatomegaly (HP:0002240): Abnormally increased size of the liver. Evidence: TAS. Frequency: Frequent (HP:0040282). (ORPHA:97261)
- Episodic abdominal pain (HP:0002574): An intermittent form of abdominal pain. Evidence: TAS. Frequency: Frequent (HP:0040282). (ORPHA:97261)
- Neoplasm of the pancreas (HP:0002894): A tumor (abnormal growth of tissue) of the pancreas. Evidence: TAS. Frequency: Frequent (HP:0040282). (ORPHA:97261)
- Increased circulating cortisol level (HP:0003118): Overproduction of the hormone of cortisol by the adrenal cortex, resulting in a characteristic combination of clinical symptoms termed Cushing syndrome, with truncal obesity, a round, full face, striae atrophicae and acne, muscle weakness, and other features. Evidence: TAS. Frequency: Frequent (HP:0040282). (ORPHA:97261)
- Poor appetite (HP:0004396): A reduced desire to eat. Evidence: TAS. Frequency: Frequent (HP:0040282). (ORPHA:97261)
- Palmoplantar hyperhidrosis (HP:0007410): An abnormally increased perspiration on palms and soles. Evidence: TAS. Frequency: Frequent (HP:0040282). (ORPHA:97261)
- Hypoactive bowel sounds (HP:0030144): An decreased amount of bowel sounds. Evidence: TAS. Frequency: Frequent (HP:0040282). (ORPHA:97261)
- Neoplasm of the lung (HP:0100526): Tumor of the lung. Evidence: TAS. Frequency: Frequent (HP:0040282). (ORPHA:97261)
- Abnormality of the thyroid gland (HP:0000820): An abnormality of the thyroid gland. Evidence: TAS. Frequency: Occasional (HP:0040283). (ORPHA:97261)
- Increased circulating gonadotropin level (HP:0000837): Overproduction of gonadotropins (FSH, LH) by the anterior pituitary gland. Evidence: TAS. Frequency: Occasional (HP:0040283). (ORPHA:97261)
- Increased circulating prolactin concentration (HP:0000870): The presence of abnormally increased levels of prolactin in the blood. Prolactin is a peptide hormone produced by the anterior pituitary gland that plays a role in breast development and lactation during pregnancy. Evidence: TAS. Frequency: Occasional (HP:0040283). (ORPHA:97261)
- Subcutaneous lipoma (HP:0001031): The presence of subcutaneous lipoma. Evidence: TAS. Frequency: Occasional (HP:0040283). (ORPHA:97261)
- Intermittent jaundice (HP:0001046): Jaundice that is sometimes present, sometimes not. Evidence: TAS. Frequency: Occasional (HP:0040283). (ORPHA:97261)
- Cholelithiasis (HP:0001081): Hard, pebble-like deposits that form within the gallbladder. Evidence: TAS. Frequency: Occasional (HP:0040283). (ORPHA:97261)
- Intrahepatic cholestasis (HP:0001406): Impairment of bile flow due to obstruction in the small bile ducts within the liver. Evidence: TAS. Frequency: Occasional (HP:0040283). (ORPHA:97261)
- Ascites (HP:0001541): Accumulation of fluid in the peritoneal cavity (between the layers of the peritoneum that lines the abdomen). Evidence: TAS. Frequency: Occasional (HP:0040283). (ORPHA:97261)
- Gastrointestinal hemorrhage (HP:0002239): Hemorrhage affecting the gastrointestinal tract. Evidence: TAS. Frequency: Occasional (HP:0040283). (ORPHA:97261)
- Pituitary adenoma (HP:0002893): A benign epithelial tumor derived from intrinsic cells of the adenohypophysis (anterior pituitary). Evidence: TAS. Frequency: Occasional (HP:0040283). (ORPHA:97261)
- Parathyroid adenoma (HP:0002897): A benign tumor of the parathyroid gland that can cause hyperparathyroidism. Evidence: TAS. Frequency: Occasional (HP:0040283). (ORPHA:97261)
- Hypercalcemia (HP:0003072): The concentration of calcium in the blood circulation is above the upper limit of normal. Evidence: TAS. Frequency: Occasional (HP:0040283). (ORPHA:97261)
- Intestinal obstruction (HP:0005214): Blockage or impairment of the normal flow of the contents of the intestine towards the anal canal. Evidence: TAS. Frequency: Occasional (HP:0040283). (ORPHA:97261)
- Intestinal carcinoid (HP:0006723). Evidence: TAS. Frequency: Occasional (HP:0040283). (ORPHA:97261)
- Primary hyperparathyroidism (HP:0008200): A type of hyperparathyroidism caused by a primary abnormality of the parathyroid glands (e.g., adenoma, carcinoma, hyperplasia). Primary hyperparathyroidism is associated with hyercalcemia. Evidence: TAS. Frequency: Occasional (HP:0040283). (ORPHA:97261)
- Adrenocortical adenoma (HP:0008256): Adrenocortical adenomas are benign tumors of the adrenal cortex. Evidence: TAS. Frequency: Occasional (HP:0040283). (ORPHA:97261)
- Extrahepatic cholestasis (HP:0012334): Impairment of bile flow due to obstruction in large bile ducts outside the liver. Evidence: TAS. Frequency: Occasional (HP:0040283). (ORPHA:97261)
- Lack of bowel sounds (HP:0030145): Complete lack of abdominal sounds as assayed by examination of the abdomen with a stethoscope. Evidence: TAS. Frequency: Occasional (HP:0040283). (ORPHA:97261)
- Neoplasm of the small intestine (HP:0100833): The presence of a neoplasm of the small intestine. Evidence: TAS. Frequency: Occasional (HP:0040283). (ORPHA:97261)
- Pheochromocytoma (HP:0002666): Pheochromocytomas (also known as chromaffin tumors) produce, store, and secrete catecholamines. Pheochromocytomas usually originate from the adrenal medulla but may also develop from chromaffin cells in or about sympathetic ganglia. A common symptom of pheochromocytoma is hypertension owing to release of catecholamines. Evidence: TAS. Frequency: Very rare (HP:0040284). (ORPHA:97261)
- Neoplasm of the thymus (HP:0100521): A tumor (abnormal growth of tissue) of the thymus. Evidence: TAS. Frequency: Very rare (HP:0040284). (ORPHA:97261)
These phenotypes are associated with the disease GRFoma (ORPHA:97261).